Phenotypes associated with the disease mitochondrial complex I deficiency, nuclear type 3 (OMIM:618224):
- Encephalopathy (HP:0001298): Encephalopathy is a term that means brain disease, damage, or malfunction. In general, encephalopathy is manifested by an altered mental state. Evidence: IEA. (OMIM:618224)
- Lethargy (HP:0001254): A state of fatigue, either physical or mental slowness and sluggishness, with difficulties in initiating or performing simple tasks. Distinguished from apathy which implies indifference and a lack of desire or interest in the task. A person with lethargy may have the desire, but not the energy to engage in personal or socially relevant tasks. Evidence: IEA. (OMIM:618224)
- Progressive (HP:0003676): Applies to a disease manifestation that increases in scope or severity over the course of time, i.e., that worsens with age. Evidence: PCS. (PMID:10330338)
- Developmental regression (HP:0002376): Loss of developmental skills, as manifested by loss of developmental milestones. Evidence: IEA. (OMIM:618224)
- Dystonia (HP:0001332): An abnormally increased muscular tone that causes fixed abnormal postures. There is a slow, intermittent twisting motion that leads to exaggerated turning and posture of the extremities and trunk. Evidence: IEA. (OMIM:618224)
- Seizure (HP:0001250): A seizure is an intermittent abnormality of nervous system physiology characterized by a transient occurrence of signs and/or symptoms due to abnormal excessive or synchronous neuronal activity in the brain. Evidence: IEA. (OMIM:618224)
- Feeding difficulties (HP:0011968): Impaired ability to eat related to problems gathering food and getting ready to suck, chew, or swallow it. Evidence: PCS. Frequency: 1/2. (PMID:10330338)
- Dysarthria (HP:0001260): Dysarthric speech is a general description referring to a neurological speech disorder characterized by poor articulation. Depending on the involved neurological structures, dysarthria may be further classified as spastic, flaccid, ataxic, hyperkinetic and hypokinetic, or mixed. Evidence: PCS. Frequency: 1/2. (PMID:10330338)
- Episodic vomiting (HP:0002572): Paroxysmal, recurrent episodes of vomiting. Evidence: PCS. Frequency: 1/2. (PMID:10330338)
- Ataxia (HP:0001251): Ataxia refers to impaired coordination of voluntary muscle movement. Cerebellar ataxia refers to ataxia due to dysfunction of the cerebellum. This causes a variety of elementary neurological deficits including asynergy (lack of coordination between muscles, limbs and joints), dysmetria (lack of ability to judge distances that can lead to under- or overshoot in grasping movements), and dysdiadochokinesia (inability to perform rapid movements requiring antagonizing muscle groups to be switched on and off repeatedly). Evidence: PCS. Frequency: 1/2. (PMID:10330338)
- Hepatomegaly (HP:0002240): Abnormally increased size of the liver. Evidence: IEA. (OMIM:618224)
- Generalized hypotonia (HP:0001290): Generalized muscular hypotonia (abnormally low muscle tone). Evidence: IEA. (OMIM:618224)
- Abnormality of extrapyramidal motor function (HP:0002071): A neurological condition related to lesions of the basal ganglia leading to typical abnormalities including akinesia (inability to initiate changes in activity and perform volitional movements rapidly and easily), muscular rigidity (continuous contraction of muscles with constant resistance to passive movement), chorea (widespread arrhythmic movements of a forcible, rapid, jerky, and restless nature), athetosis (inability to sustain the muscles of the fingers, toes, or other group of muscles in a fixed position), and akathisia (inability to remain motionless). Evidence: IEA. (OMIM:618224)
- Respiratory insufficiency (HP:0002093). Evidence: IEA. (OMIM:618224)
- Death in childhood (HP:0003819): Death in during childhood, defined here as between the ages of 2 and 10 years. Evidence: PCS. Frequency: 2/2. (PMID:10330338)
- Abnormal pyramidal sign (HP:0007256): Functional neurological abnormalities related to dysfunction of the pyramidal tract. Evidence: IEA. (OMIM:618224)
- Autosomal recessive inheritance (HP:0000007): A mode of inheritance that is observed for traits related to a gene encoded on one of the autosomes (i.e., the human chromosomes 1-22) in which a trait manifests in individuals with two pathogenic alleles, either homozygotes (two copies of the same mutant allele) or compound heterozygotes (whereby each copy of a gene has a distinct mutant allele). Evidence: PCS. (PMID:10330338)
- Metabolic acidosis (HP:0001942): Metabolic acidosis (MA) is characterized by a fall in blood pH due to a reduction of serum bicarbonate concentration. This can occur as a result of either the accumulation of acids (high anion gap MA) or the loss of bicarbonate from the gastrointestinal tract or the kidney (hyperchloremic MA). By definition, MA is not due to a respirary cause. Evidence: IEA. (OMIM:618224)
- Hyperreflexia (HP:0001347): Hyperreflexia is the presence of hyperactive stretch reflexes of the muscles. Evidence: IEA. (OMIM:618224)